Phenotypes associated with the disease HYPERTENSION, DIASTOLIC, RESISTANCE TO (OMIM:608622):
- Elevated diastolic blood pressure (HP:0005117): Abnormal increase in diastolic blood pressure. Evidence: TAS. (OMIM:608622)
- Autosomal dominant inheritance (HP:0000006): A mode of inheritance that is observed for traits related to a gene encoded on one of the autosomes (i.e., the human chromosomes 1-22) in which a trait manifests in heterozygotes. In the context of medical genetics, an autosomal dominant disorder is caused when a single copy of the mutant allele is present. Males and females are affected equally, and can both transmit the disorder with a risk of 50% for each child of inheriting the mutant allele. Evidence: IEA. (OMIM:608622)